- Thin upper lip vermilion (HP:0000219): Height of the vermilion of the upper lip in the midline more than 2 SD below the mean. Alternatively, an apparently reduced height of the vermilion of the upper lip in the frontal view (subjective). Evidence: TAS. Frequency: Very frequent (HP:0040281). (ORPHA:2512)
- Microcephaly (HP:0000252): Head circumference below 2 standard deviations below the mean for age and gender. Evidence: TAS. Frequency: Very frequent (HP:0040281). (ORPHA:2512)
- Sloping forehead (HP:0000340): Inclination of the anterior surface of the forehead from the vertical more than two standard deviations above the mean (objective); or apparently excessive posterior sloping of the forehead in a lateral view. Evidence: TAS. Frequency: Very frequent (HP:0040281). (ORPHA:2512)
- Upslanted palpebral fissure (HP:0000582): The palpebral fissure inclination is more than two standard deviations above the mean for age (objective); or, the inclination of the palpebral fissure is greater than typical for age. Evidence: TAS. Frequency: Very frequent (HP:0040281). (ORPHA:2512)
- Global developmental delay (HP:0001263): A delay in the achievement of motor or mental milestones in the domains of development of a child, including motor skills, speech and language, cognitive skills, and social and emotional skills. This term should only be used to describe children younger than five years of age. Evidence: TAS. Frequency: Very frequent (HP:0040281). (ORPHA:2512)
- Growth delay (HP:0001510): A deficiency or slowing down of growth pre- and postnatally. Evidence: TAS. Frequency: Very frequent (HP:0040281). (ORPHA:2512)
- Gray matter heterotopia (HP:0002282): Heterotopia or neuronal heterotopia are macroscopic clusters of misplaced neurons (gray matter), most often situated along the ventricular walls or within the subcortical white matter. Evidence: TAS. Frequency: Very frequent (HP:0040281). (ORPHA:2512)
- Short stature (HP:0004322): A height below that which is expected according to age and gender norms. Although there is no universally accepted definition of short stature, many refer to "short stature" as height more than 2 standard deviations below the mean for age and gender (or below the 3rd percentile for age and gender dependent norms). Evidence: TAS. Frequency: Very frequent (HP:0040281). (ORPHA:2512)
- Severe intellectual disability (HP:0010864): Severe intellectual disability (ID) is defined as a type of ID characterized by severely sub-average adaptive functioning and intellectual functioning, with an intelligence quotient (IQ) the range of 20-34. Evidence: TAS. Frequency: Very frequent (HP:0040281). (ORPHA:2512)
- Vesicoureteral reflux (HP:0000076): Abnormal (retrograde) movement of urine from the bladder into ureters or kidneys related to inadequacy of the valvular mechanism at the ureterovesicular junction or other causes. Evidence: TAS. Frequency: Frequent (HP:0040282). (ORPHA:2512)
- Unilateral renal agenesis (HP:0000122): A unilateral form of agenesis of the kidney. Evidence: TAS. Frequency: Frequent (HP:0040282). (ORPHA:2512)
- Agenesis of corpus callosum (HP:0001274): Absence of the corpus callosum as a result of the failure of the corpus callosum to develop, which can be the result of a failure in any one of the multiple steps of callosal development including cellular proliferation and migration, axonal growth or glial patterning at the midline. Evidence: TAS. Frequency: Frequent (HP:0040282). (ORPHA:2512)
- Pachygyria (HP:0001302): Pachygyria is a malformation of cortical development with abnormally wide gyri with sulci 1,5-3 cm apart and abnormally thick cortex measuring more than 5 mm (radiological definition). See also neuropathological definitions for 2-, 3-, and 4-layered lissencephaly. Evidence: TAS. Frequency: Frequent (HP:0040282). (ORPHA:2512)
- Hyperreflexia (HP:0001347): Hyperreflexia is the presence of hyperactive stretch reflexes of the muscles. Evidence: TAS. Frequency: Frequent (HP:0040282). (ORPHA:2512)
- Ventriculomegaly (HP:0002119): An increase in size of the ventricular system of the brain. Evidence: TAS. Frequency: Frequent (HP:0040282). (ORPHA:2512)
- Abnormal cortical bone morphology (HP:0003103): An abnormality of compact bone (also known as cortical bone), which forms the dense surface of bones. Evidence: TAS. Frequency: Frequent (HP:0040282). (ORPHA:2512)
- Hypoplasia of the frontal lobes (HP:0007333): Underdevelopment of the frontal lobe of the cerebrum. Evidence: TAS. Frequency: Frequent (HP:0040282). (ORPHA:2512)
These phenotypes are associated with the disease Autosomal recessive primary microcephaly (ORPHA:2512).